Phenotypes associated with the disease intellectual developmental disorder, autosomal recessive 73 (OMIM:619717):
- Epicanthus (HP:0000286): A fold of skin starting above the medial aspect of the upper eyelid and arching downward to cover, pass in front of and lateral to the medial canthus. Evidence: PCS. Frequency: 1/5. (PMID:34230638)
- Poor speech (HP:0002465). Evidence: PCS. Frequency: 1/5. (PMID:34230638)
- Impaired mastication (HP:0005216): An abnormal reduction in the ability to masticate (chew), i.e., in the ability to crush and ground food in preparation for swallowing. Evidence: PCS. Frequency: 1/5. (PMID:34230638)
- Narrow forehead (HP:0000341): Width of the forehead or distance between the frontotemporales is more than two standard deviations below the mean (objective); or apparently narrow intertemporal region (subjective). Evidence: PCS. Frequency: 1/5. (PMID:34230638)
- Deep philtrum (HP:0002002): Accentuated, prominent philtral ridges giving rise to an exaggerated groove in the midline between the nasal base and upper vermillion border. Evidence: PCS. Frequency: 1/5. (PMID:34230638)
- Antenatal onset (HP:0030674): Onset prior to birth. Evidence: PCS. Frequency: 3/5. (PMID:34230638)
- Gait ataxia (HP:0002066): A type of ataxia characterized by the impairment of the ability to coordinate the movements required for normal walking. Gait ataxia is characteirzed by a wide-based staggering gait with a tendency to fall. Evidence: PCS. Frequency: 1/5. (PMID:34230638)
- Hypotonia (HP:0001252): Hypotonia is an abnormally low muscle tone (the amount of tension or resistance to movement in a muscle). Even when relaxed, muscles have a continuous and passive partial contraction which provides some resistance to passive stretching. Hypotonia thus manifests as diminished resistance to passive stretching. Hypotonia is not the same as muscle weakness, although the two conditions can co-exist. Evidence: PCS. Frequency: 1/5. (PMID:34230638)
- Infantile onset (HP:0003593): Onset of signs or symptoms of disease between 28 days to one year of life. Evidence: PCS. Frequency: 1/5. (PMID:34230638)
- Generalized hypotonia (HP:0001290): Generalized muscular hypotonia (abnormally low muscle tone). Evidence: PCS. Frequency: 2/5. (PMID:34230638)
- Ventricular septal defect (HP:0001629): A hole between the two bottom chambers (ventricles) of the heart. The defect is centered around the most superior aspect of the ventricular septum. Evidence: PCS. Frequency: 2/5. (PMID:34230638)
- Irritability (HP:0000737): An emotional state characterized by negative feelings of heightened frustration, annoyance, or feeling upset, often triggered by internal factors (e.g., fatigue, hunger, unfulfilled desires) or external factors (e.g., social or environmental challenges). Irritability may be unpredictable, and is accompanied by a lowered threshold for emotional reactivity and observable features (speech, facial expressions, or psychomotor activity). Evidence: PCS. Frequency: 1/5. (PMID:34230638)
- Osteopenia (HP:0000938): Osteopenia is a term to define bone density that is not normal but also not as low as osteoporosis. By definition from the World Health Organization osteopenia is defined by bone densitometry as a T score -1 to -2.5. Evidence: PCS. Frequency: 1/5. (PMID:34230638)
- Autism (HP:0000717): Autism is a neurodevelopmental disorder characterized by impaired social interaction and communication, and by restricted and repetitive behavior. Autism begins in childhood. It is marked by the presence of markedly abnormal or impaired development in social interaction and communication and a markedly restricted repertoire of activity and interest. Manifestations of the disorder vary greatly depending on the developmental level and chronological age of the individual (DSM-IV). Evidence: PCS. Frequency: 1/5. (PMID:34230638)
- Single transverse palmar crease (HP:0000954): The distal and proximal transverse palmar creases are merged into a single transverse palmar crease. Evidence: PCS. Frequency: 2/5. (PMID:34230638)
- Patent ductus arteriosus (HP:0001643): In utero, the ductus arteriosus (DA) serves to divert ventricular output away from the lungs and toward the placenta by connecting the main pulmonary artery to the descending aorta. A patent ductus arteriosus (PDA) in the first 3 days of life is a physiologic shunt in healthy term and preterm newborn infants, and normally is substantially closed within about 24 hours after bith and completely closed after about three weeks. Failure of physiologcal closure is referred to a persistent or patent ductus arteriosus (PDA). Depending on the degree of left-to-right shunting, PDA can have clinical consequences. Evidence: PCS. Frequency: 1/5. (PMID:34230638)
- Pes planus (HP:0001763): A foot where the longitudinal arch of the foot is in contact with the ground or floor when the individual is standing; or, in a patient lying supine, a foot where the arch is in contact with the surface of a flat board pressed against the sole of the foot by the examiner with a pressure similar to that expected from weight bearing; or, the height of the arch is reduced. Evidence: PCS. Frequency: 1/5. (PMID:34230638)
- Intellectual disability (HP:0001249): The term intellectual disability or intellectual developmental disorder is used to describe significantly sub-average intellectual and adaptive functioning based on clinical assessment and as measured by individually administered, appropriately normed, standardized and validated tests of intellectual functioning and adaptive behavior, with onset during the developmental period from infancy through adolescence. Evidence: PCS. Frequency: 3/3. (PMID:34230638)
- Thick upper lip vermilion (HP:0000215): Height of the vermilion of the upper lip in the midline more than 2 SD above the mean. Alternatively, an apparently increased height of the vermilion of the upper lip in the frontal view (subjective). Evidence: PCS. Frequency: 1/5. (PMID:34230638)
- Posteriorly rotated ears (HP:0000358): A type of abnormal location of the ears in which the position of the ears is characterized by posterior rotation (the superior part of the ears is rotated towards the back of the head, and the inferior part of the ears towards the front). Evidence: PCS. Frequency: 1/5. (PMID:34230638)
- Hyperreflexia (HP:0001347): Hyperreflexia is the presence of hyperactive stretch reflexes of the muscles. Evidence: PCS. Frequency: 1/5. (PMID:34230638)
- Neonatal onset (HP:0003623): Onset of signs or symptoms of disease within the first 28 days of life. Evidence: PCS. Frequency: 1/5. (PMID:34230638)
- Incoordination (HP:0002311): A deficit in coordination of muscle movements. Coordination is defined as the orchestrated movement of multiple body parts as required to accomplish intended actions, like walking. Evidence: PCS. Frequency: 1/5. (PMID:34230638)
- Downslanted palpebral fissures (HP:0000494): The palpebral fissure inclination is more than two standard deviations below the mean. Evidence: PCS. Frequency: 2/5. (PMID:34230638)
- Scoliosis (HP:0002650): The presence of an abnormal lateral curvature of the spine. Evidence: PCS. Frequency: 1/5. (PMID:34230638)
- Feeding difficulties (HP:0011968): Impaired ability to eat related to problems gathering food and getting ready to suck, chew, or swallow it. Evidence: PCS. Frequency: 1/5. (PMID:34230638)
- Poor suck (HP:0002033): An inadequate sucking reflex, resulting in the difficult of newborns to be breast-fed. Evidence: PCS. Frequency: 1/5. (PMID:34230638)
- Global developmental delay (HP:0001263): A delay in the achievement of motor or mental milestones in the domains of development of a child, including motor skills, speech and language, cognitive skills, and social and emotional skills. This term should only be used to describe children younger than five years of age. Evidence: PCS. Frequency: 5/5. (PMID:34230638)
- Small forehead (HP:0000350): The presence of a forehead that is abnormally small. Evidence: PCS. Frequency: 1/5. (PMID:34230638)
- Persistent head lag (HP:0032988): The Premie-Neuro and the Dubowitz Neurological Examination score head lag in the same manner. Scoring for both is as follows: 0 = head drops and stays back, 1 = tries to lift head but drops it back, 2 = able to lift head slightly, 3 = lifts head in line with body, and 4 = head in front of body. This term applies if head lag persists beyond an expected age at a level of 0 or 1. Persistent head lag beyond age 4 mo has been linked to poor outcomes. Evidence: PCS. Frequency: 1/5. (PMID:34230638)
- Recurrent hand flapping (HP:0100023): A type of repetitive behavior in which the affected individual repeatedly waves the hands and/or arms rhythmically. Evidence: PCS. Frequency: 1/5. (PMID:34230638)
- Impulsivity (HP:0100710): Acting on the spur of the moment or on a momentary basis without consideration of outcomes; having difficulty establishing or following plans; experiencing a sense of urgency and engaging in behavior that is uninhibited, cannot be inhibited, and is uncontrolled. The possibility of repression is inconceivable. Evidence: PCS. Frequency: 1/5. (PMID:34230638)
- Autosomal recessive inheritance (HP:0000007): A mode of inheritance that is observed for traits related to a gene encoded on one of the autosomes (i.e., the human chromosomes 1-22) in which a trait manifests in individuals with two pathogenic alleles, either homozygotes (two copies of the same mutant allele) or compound heterozygotes (whereby each copy of a gene has a distinct mutant allele). Evidence: PCS. (PMID:34230638)
- Decreased fetal movement (HP:0001558): An abnormal reduction in quantity or strength of fetal movements. Evidence: PCS. Frequency: 2/5. (PMID:34230638)
- Clinodactyly of the 5th finger (HP:0004209): Clinodactyly refers to a bending or curvature of the fifth finger in the radial direction (i.e., towards the 4th finger). Evidence: PCS. Frequency: 2/5. (PMID:34230638)
- Drooling (HP:0002307): Habitual flow of saliva out of the mouth. Evidence: PCS. Frequency: 1/5. (PMID:34230638)
- Dolichocephaly (HP:0000268): An abnormality of skull shape characterized by a increased anterior-posterior diameter, i.e., an increased antero-posterior dimension of the skull. Cephalic index less than 76%. Alternatively, an apparently increased antero-posterior length of the head compared to width. Often due to premature closure of the sagittal suture. Evidence: PCS. Frequency: 1/5. (PMID:34230638)
- Low-set ears (HP:0000369): Upper insertion of the ear to the scalp below an imaginary horizontal line drawn between the inner canthi of the eye and extending posteriorly to the ear. Evidence: PCS. Frequency: 1/5. (PMID:34230638)
- Widely spaced teeth (HP:0000687): Increased spaces (diastemata) between most of the teeth in the same dental arch. Evidence: PCS. Frequency: 1/5. (PMID:34230638)